Phenotypes associated with the disease Fuchs heterochromic iridocyclitis (ORPHA:263479):
- Iris atrophy (HP:0001089): Loss of iris tissue (atrophy). Evidence: TAS. Frequency: Very frequent (HP:0040281). (ORPHA:263479)
- Corneal keratic precipitates (HP:0025341): An inflammatory cellular deposit deposited on the corneal endothelium and visible as spots on the cornea. Evidence: TAS. Frequency: Very frequent (HP:0040281). (ORPHA:263479)
- Anterior chamber inflammatory cells (HP:0031701): The presence of inflammatory cells in the aqueous humor of the anterior chamber of the eye. Evidence: TAS. Frequency: Very frequent (HP:0040281). (ORPHA:263479)
- Vitreous floaters (HP:0100832): Deposits of various size, shape, consistency, refractive index, and motility within the eye's vitreous humor, which is normally transparent. Evidence: TAS. Frequency: Very frequent (HP:0040281). (ORPHA:263479)
- Cataract (HP:0000518): A cataract is an opacity or clouding that develops in the crystalline lens of the eye or in its capsule. Evidence: TAS. Frequency: Frequent (HP:0040282). (ORPHA:263479)
- Blurred vision (HP:0000622): Lack of sharpness of vision resulting in the inability to see fine detail. Evidence: TAS. Frequency: Frequent (HP:0040282). (ORPHA:263479)
- Heterochromia iridis (HP:0001100): Heterochromia iridis is a difference in the color of the iris in the two eyes. Evidence: TAS. Frequency: Frequent (HP:0040282). (ORPHA:263479)
- Koeppe nodules (HP:0034820): A type of iris nodule consisting of inflammatory cell precipitates which lie at the pupillary margin. Evidence: TAS. Frequency: Frequent (HP:0040282). (ORPHA:263479)
- Bussaca nodules (HP:0034821): A type of iris nodule consisting of inflammatory cell precipitates which lie on the iris surface. Evidence: TAS. Frequency: Frequent (HP:0040282). (ORPHA:263479)
- Glaucoma (HP:0000501): Glaucoma refers loss of retinal ganglion cells in a characteristic pattern of optic neuropathy usually associated with increased intraocular pressure. Evidence: TAS. Frequency: Occasional (HP:0040283). (ORPHA:263479)
- Photophobia (HP:0000613): Excessive sensitivity to light with the sensation of discomfort or pain in the eyes due to exposure to bright light. Evidence: TAS. Frequency: Occasional (HP:0040283). (ORPHA:263479)
- Papilledema (HP:0001085): Papilledema refers to edema (swelling) of the optic disc secondary to any factor which increases cerebral spinal fluid pressure. Evidence: TAS. Frequency: Occasional (HP:0040283). (ORPHA:263479)
- Reduced visual acuity (HP:0007663). Evidence: TAS. Frequency: Occasional (HP:0040283). (ORPHA:263479)
- Chorioretinal scar (HP:0007777): Fibrous connective tissue resulting from incomplete healing of a wound (i.e., a scar) located in the choroid and retina or the eye. Evidence: TAS. Frequency: Occasional (HP:0040283). (ORPHA:263479)
- Ocular hypertension (HP:0007906): Intraocular pressure that is 2 standard deviations above the population mean. Evidence: TAS. Frequency: Occasional (HP:0040283). (ORPHA:263479)
- Red eye (HP:0025337): A reddish appearance over the white part (sclera) of the eye ranging from a few enlarged blood vessels appearing as wiggly lines over the sclera to a bright red color completely covering to sclera. Evidence: TAS. Frequency: Occasional (HP:0040283). (ORPHA:263479)
- Abnormal best corrected visual acuity test (HP:0030534). Evidence: TAS. Frequency: Occasional (HP:0040283). (ORPHA:263479)
- Ocular pain (HP:0200026): An unpleasant sensation characterized by physical discomfort (such as pricking, throbbing, or aching) localized to the eye. Evidence: TAS. Frequency: Occasional (HP:0040283). (ORPHA:263479)
- Optic disc pallor (HP:0000543): A pale yellow discoloration of the optic disc (the area of the optic nerve head in the retina). The optic disc normally has a pinkish hue with a central yellowish depression. Evidence: TAS. Frequency: Very rare (HP:0040284). (ORPHA:263479)
- Anisocoria (HP:0009916): Anisocoria, or unequal pupil size, may represent a benign physiologic variant or a manifestation of disease. Evidence: TAS. Frequency: Very rare (HP:0040284). (ORPHA:263479)
- Retinal perforation (HP:0011958): A hole through the whole thickness of the retina, associated with trauma. Evidence: TAS. Frequency: Very rare (HP:0040284). (ORPHA:263479)
- Best corrected visual acuity 0.1 LogMAR (HP:0030554). Evidence: TAS. Frequency: Very rare (HP:0040284). (ORPHA:263479)
- Epiretinal membrane (HP:0100014): An epiretinal membrane is a thin sheet of fibrous tissue on the surface of the retina along the inner limiting membrane. It appears as a greyish semi-translucent avascular membrane over the internal limiting membrane (ILM) on the surface of the retina. Evidence: TAS. Frequency: Very rare (HP:0040284). (ORPHA:263479)
Not associated with this disease:
- Posterior synechiae of the anterior chamber (HP:0011484): Adhesions between the iris and the lens. Evidence: TAS. (ORPHA:263479)